- Short stature (HP:0004322): A height below that which is expected according to age and gender norms. Although there is no universally accepted definition of short stature, many refer to "short stature" as height more than 2 standard deviations below the mean for age and gender (or below the 3rd percentile for age and gender dependent norms). Evidence: IEA. (OMIM:135950)
- Intrauterine growth retardation (HP:0001511): An abnormal restriction of fetal growth with fetal weight below the tenth percentile for gestational age. Evidence: TAS. (OMIM:135950)
- Autosomal dominant inheritance (HP:0000006): A mode of inheritance that is observed for traits related to a gene encoded on one of the autosomes (i.e., the human chromosomes 1-22) in which a trait manifests in heterozygotes. In the context of medical genetics, an autosomal dominant disorder is caused when a single copy of the mutant allele is present. Males and females are affected equally, and can both transmit the disorder with a risk of 50% for each child of inheriting the mutant allele. Evidence: IEA. (OMIM:135950)
These phenotypes are associated with the disease Eng-Strom syndrome (OMIM:135950).